- Weight loss (HP:0001824): Reduction of total body weight. Evidence: TAS. Frequency: Frequent (HP:0040282). (ORPHA:90081)
- Malabsorption (HP:0002024): Impaired ability to absorb one or more nutrients from the intestine. Evidence: TAS. Frequency: Frequent (HP:0040282). (ORPHA:90081)
- Anorexia (HP:0002039): Lack of desire to eat (loss of appetite). Evidence: TAS. Frequency: Frequent (HP:0040282). (ORPHA:90081)
- Immunodeficiency (HP:0002721): Failure of the immune system to protect the body adequately from infection, due to the absence or insufficiency of some component process or substance. Evidence: TAS. Frequency: Frequent (HP:0040282). (ORPHA:90081)
- Skeletal muscle atrophy (HP:0003202): The presence of skeletal muscular atrophy (which is also known as amyotrophy). Evidence: TAS. Frequency: Frequent (HP:0040282). (ORPHA:90081)
- Cachexia (HP:0004326): Severe weight loss, wasting of muscle, loss of appetite, and general debility related to a chronic disease. Evidence: TAS. Frequency: Frequent (HP:0040282). (ORPHA:90081)
- Malnutrition (HP:0004395): A deficiency in the intake of energy and nutrients. Evidence: TAS. Frequency: Frequent (HP:0040282). (ORPHA:90081)
- Abnormal gonadotropin-releasing hormone concentration (HP:0500012): A deviation from the normal circulating concentration of the normal gonadotropin-releasing hormone (GnRH). Intermittent GnRH secretion from the hypothalamus acts upon its receptor in the anterior pituitary to regulate the production and release of the gonadotropins, follicle-stimulating hormone (FSH) and luteinizing hormone (LH). Evidence: TAS. Frequency: Frequent (HP:0040282). (ORPHA:90081)
These phenotypes are associated with the disease AIDS wasting syndrome (ORPHA:90081).